- Peripheral axonal neuropathy (HP:0003477): An abnormality characterized by disruption of the normal functioning of peripheral axons. Evidence: TAS. Frequency: Frequent (HP:0040282). (OMIM:610357)
- Babinski sign (HP:0003487): Upturning of the big toe (and sometimes fanning of the other toes) in response to stimulation of the sole of the foot. If the Babinski sign is present it can indicate damage to the corticospinal tract. Evidence: IEA. (OMIM:610357)
- Dysmetria (HP:0001310): A type of ataxia characterized by the inability to carry out movements with the correct range and motion across the plane of more than one joint related to incorrect estimation of the distances required for targeted movements. Evidence: TAS. Frequency: Frequent (HP:0040282). (OMIM:610357)
- Cerebellar atrophy (HP:0001272): Cerebellar atrophy is defined as a cerebellum with initially normal structures, in a posterior fossa with normal size, which displays enlarged fissures (interfolial spaces) in comparison to the foliae secondary to loss of tissue. Cerebellar atrophy implies irreversible loss of tissue and result from an ongoing progressive disease until a final stage is reached or a single injury, e.g. an intoxication or infectious event. Evidence: IEA. (OMIM:610357)
- Ataxia (HP:0001251): Ataxia refers to impaired coordination of voluntary muscle movement. Cerebellar ataxia refers to ataxia due to dysfunction of the cerebellum. This causes a variety of elementary neurological deficits including asynergy (lack of coordination between muscles, limbs and joints), dysmetria (lack of ability to judge distances that can lead to under- or overshoot in grasping movements), and dysdiadochokinesia (inability to perform rapid movements requiring antagonizing muscle groups to be switched on and off repeatedly). Evidence: TAS. Frequency: Frequent (HP:0040282). (OMIM:610357)
- Spastic gait (HP:0002064): Spasticity is manifested by increased stretch reflex which is intensified with movement velocity. This results in excessive and inappropriate muscle activation which can contribute to muscle hypertonia. Spastic gait is characterized by manifestations such as muscle hypertonia, stiff knee, and circumduction of the leg. Evidence: IEA. (OMIM:610357)
- Lower limb spasticity (HP:0002061): Spasticity (velocity-dependent increase in tonic stretch reflexes with increased muscle tone and hyperexcitable tendon reflexes) in the muscles of the lower limbs, hips, and pelvis. Evidence: IEA. (OMIM:610357)
- Ankle clonus (HP:0011448): Clonus is an involuntary tendon reflex that causes repeated flexion and extension of the foot. Ankle clonus is tested by rapidly flexing the foot upward. Evidence: TAS. (OMIM:610357)
- Lower limb muscle weakness (HP:0007340): Weakness of the muscles of the legs. Evidence: TAS. Frequency: Frequent (HP:0040282). (OMIM:610357)
- Lower limb amyotrophy (HP:0007210): Muscular atrophy affecting the lower limb. Evidence: TAS. Frequency: Frequent (HP:0040282). (OMIM:610357)
- Urinary bladder sphincter dysfunction (HP:0002839): Abnormal function of a sphincter of the urinary bladder. Evidence: IEA. (OMIM:610357)
- Autosomal recessive inheritance (HP:0000007): A mode of inheritance that is observed for traits related to a gene encoded on one of the autosomes (i.e., the human chromosomes 1-22) in which a trait manifests in individuals with two pathogenic alleles, either homozygotes (two copies of the same mutant allele) or compound heterozygotes (whereby each copy of a gene has a distinct mutant allele). Evidence: IEA. (OMIM:610357)
- Spastic paraplegia (HP:0001258): Complete loss of the ability to move the lower limbs accompanied by spasticity of the lower limbs. Evidence: TAS. (OMIM:610357)
- Slowly progressive (HP:0003677): Applies to a disease manifestation that only slowly increases in scope or severity over the course of time. Evidence: IEA. (OMIM:610357)
- Autosomal dominant inheritance (HP:0000006): A mode of inheritance that is observed for traits related to a gene encoded on one of the autosomes (i.e., the human chromosomes 1-22) in which a trait manifests in heterozygotes. In the context of medical genetics, an autosomal dominant disorder is caused when a single copy of the mutant allele is present. Males and females are affected equally, and can both transmit the disorder with a risk of 50% for each child of inheriting the mutant allele. Evidence: IEA. (PMID:25585697)
- Hyperreflexia (HP:0001347): Hyperreflexia is the presence of hyperactive stretch reflexes of the muscles. Evidence: IEA. (OMIM:610357)
These phenotypes are associated with the disease spastic paraplegia 30A, autosomal dominant (OMIM:610357).